Phenotypes associated with the disease Spastic tetraplegia-retinitis pigmentosa-intellectual disability syndrome (ORPHA:3011):
- Rod-cone dystrophy (HP:0000510): An inherited retinal disease subtype in which the rod photoreceptors appear to be more severely affected than the cone photoreceptors. Typical presentation is with nyctalopia (due to rod dysfunction) followed by loss of mid-peripheral field of vision, which gradually extends and leaves many patients with a small central island of vision due to the preservation of macular cones. Evidence: TAS. Frequency: Frequent (HP:0040282). (ORPHA:3011)
- Severely reduced visual acuity (HP:0001141): Severe reduction of the ability to see. On the 6m visual acuity scale, severe reduction is defined as less than 6/60 but at least 3/60. On the 20ft visual acuity scale, severe reduction is defined as less than 20/200 but at least 20/400. On the decimal visual acuity scale, severe reduction is defined as less than 0.1 but at least 0.05. Evidence: TAS. Frequency: Frequent (HP:0040282). (ORPHA:3011)
- Profound intellectual disability (HP:0002187): Profound intellectual disability (ID) is defined as a type of ID characterized by profoundly sub-average adaptive functioning and intellectual functioning, with an intelligence quotient (IQ) below 20. Evidence: TAS. Frequency: Frequent (HP:0040282). (ORPHA:3011)
- Developmental regression (HP:0002376): Loss of developmental skills, as manifested by loss of developmental milestones. Evidence: TAS. Frequency: Frequent (HP:0040282). (ORPHA:3011)
- Infantile sensorineural hearing impairment (HP:0008610): A form of sensorineural hearing impairment with infantile onset. Evidence: TAS. Frequency: Frequent (HP:0040282). (ORPHA:3011)